- Abnormality of the dentition (HP:0000164): Any abnormality of the teeth. Evidence: PCS. Frequency: 0/13. (PMID:21412954)
- Abnormal nail morphology (HP:0001597): Abnormal structure or appearance of the nail. Evidence: PCS. Frequency: 0/13. (PMID:21412954)
- Infantile onset (HP:0003593): Onset of signs or symptoms of disease between 28 days to one year of life. Evidence: PCS. Frequency: 13/13. (PMID:21412954)
- Dry hair (HP:0011359): Hair that lacks the luster (shine or gleam) of normal hair. Evidence: PCS. Frequency: 13/13. (PMID:21412954)
- Aplasia/Hypoplasia of the eyebrow (HP:0100840): Absence or underdevelopment of the eyebrow. Evidence: PCS. Frequency: 10/13. (PMID:21412954)
- Sparse scalp hair (HP:0002209): Decreased number of hairs per unit area of skin of the scalp. Evidence: PCS. Frequency: 13/13. (PMID:21412954)
- Sparse or absent eyelashes (HP:0200102). Evidence: PCS. Frequency: 12/13. (PMID:21412954)
- Abnormal sweat gland morphology (HP:0000971): Any structural abnormality of the sweat gland. Evidence: PCS. Frequency: 0/13. (PMID:21412954)
- Slow-growing hair (HP:0002217): Hair whose growth is slower than normal. Evidence: PCS. (PMID:21412954)
- Autosomal dominant inheritance (HP:0000006): A mode of inheritance that is observed for traits related to a gene encoded on one of the autosomes (i.e., the human chromosomes 1-22) in which a trait manifests in heterozygotes. In the context of medical genetics, an autosomal dominant disorder is caused when a single copy of the mutant allele is present. Males and females are affected equally, and can both transmit the disorder with a risk of 50% for each child of inheriting the mutant allele. Evidence: PCS. (PMID:21412954)
- Sparse pubic hair (HP:0002225): Reduced number or density of pubic hair. Evidence: PCS. Frequency: 10/12. (PMID:21412954)
- Abnormality of the skin (HP:0000951): An abnormality of the skin. Evidence: PCS. Frequency: 0/13. (PMID:21412954)
- Sparse axillary hair (HP:0002215): Reduced number or density of axillary hair. Evidence: PCS. Frequency: 12/13. (PMID:21412954)
These phenotypes are associated with the disease hypotrichosis 12 (OMIM:615885).